Phenotypes associated with the disease basal cell carcinoma, susceptibility to, 7 (OMIM:614740):
- Basal cell carcinoma (HP:0002671): The presence of a basal cell carcinoma of the skin. Evidence: PCS. (PMID:21946351)
- Adult onset (HP:0003581): Onset of disease manifestations in adulthood, defined here as at the age of 16 years or later. Evidence: PCS. (PMID:21946351)
- Autosomal dominant inheritance (HP:0000006): A mode of inheritance that is observed for traits related to a gene encoded on one of the autosomes (i.e., the human chromosomes 1-22) in which a trait manifests in heterozygotes. In the context of medical genetics, an autosomal dominant disorder is caused when a single copy of the mutant allele is present. Males and females are affected equally, and can both transmit the disorder with a risk of 50% for each child of inheriting the mutant allele. Evidence: PCS. (PMID:21946351)